Phenotypes associated with the disease autosomal dominant nonsyndromic hearing loss 3A (OMIM:601544):
- Sensorineural hearing impairment (HP:0000407): A type of hearing impairment in one or both ears related to an abnormal functionality of the cochlear nerve. Evidence: TAS. (OMIM:601544)
- Autosomal dominant inheritance (HP:0000006): A mode of inheritance that is observed for traits related to a gene encoded on one of the autosomes (i.e., the human chromosomes 1-22) in which a trait manifests in heterozygotes. In the context of medical genetics, an autosomal dominant disorder is caused when a single copy of the mutant allele is present. Males and females are affected equally, and can both transmit the disorder with a risk of 50% for each child of inheriting the mutant allele. Evidence: TAS. (OMIM:601544)